Phenotypes associated with the disease Coccidioidomycosis (ORPHA:228123):
- Fever (HP:0001945): Body temperature elevated above the normal range. Evidence: TAS. Frequency: Frequent (HP:0040282). (ORPHA:228123)
- Pneumonia (HP:0002090): Inflammation of any part of the lung parenchyma. Evidence: TAS. Frequency: Frequent (HP:0040282). (ORPHA:228123)
- Immunodeficiency (HP:0002721): Failure of the immune system to protect the body adequately from infection, due to the absence or insufficiency of some component process or substance. Evidence: TAS. Frequency: Frequent (HP:0040282). (ORPHA:228123)
- Increased circulating IgG concentration (HP:0003237): An abnormally increased level of immunoglobulin G in blood. Evidence: TAS. Frequency: Frequent (HP:0040282). (ORPHA:228123)
- Increased circulating IgM concentration (HP:0003496): An abnormally increased level of immunoglobulin M in blood. Evidence: TAS. Frequency: Frequent (HP:0040282). (ORPHA:228123)
- Abnormality of the nervous system (HP:0000707): An abnormality of the nervous system. Evidence: TAS. Frequency: Occasional (HP:0040283). (ORPHA:228123)
- Atypical scarring of skin (HP:0000987): Atypically scarred skin . Evidence: TAS. Frequency: Occasional (HP:0040283). (ORPHA:228123)
- Skin rash (HP:0000988): A red eruption of the skin. Evidence: TAS. Frequency: Occasional (HP:0040283). (ORPHA:228123)
- Pruritus (HP:0000989): Pruritus is an itch or a sensation that makes a person want to scratch. This term refers to an abnormally increased disposition to experience pruritus. Evidence: TAS. Frequency: Occasional (HP:0040283). (ORPHA:228123)
- Arthritis (HP:0001369): Inflammation of a joint. Evidence: TAS. Frequency: Occasional (HP:0040283). (ORPHA:228123)
- Increased total eosinophil count (HP:0001880): Increased count of eosinophils in the blood. Evidence: TAS. Frequency: Occasional (HP:0040283). (ORPHA:228123)
- Respiratory distress (HP:0002098): Respiratory distress is objectively observable as the physical or emotional consequences from the experience of dyspnea. The physical presentation of respiratory distress is generally referred to as labored breathing, while the sensation of respiratory distress is called shortness of breath or dyspnea. Evidence: TAS. Frequency: Occasional (HP:0040283). (ORPHA:228123)
- Hemoptysis (HP:0002105): Coughing up (expectoration) of blood or blood-streaked sputum from the larynx, trachea, bronchi, or lungs. Evidence: TAS. Frequency: Occasional (HP:0040283). (ORPHA:228123)
- Pulmonary infiltrates (HP:0002113). Evidence: TAS. Frequency: Occasional (HP:0040283). (ORPHA:228123)
- Lymphadenopathy (HP:0002716): Enlargement (swelling) of a lymph node. Evidence: TAS. Frequency: Occasional (HP:0040283). (ORPHA:228123)
- Increased CSF protein concentration (HP:0002922): Increased concentration of protein in the cerebrospinal fluid. Evidence: TAS. Frequency: Occasional (HP:0040283). (ORPHA:228123)
- Myalgia (HP:0003326): Pain in muscle. Evidence: TAS. Frequency: Occasional (HP:0040283). (ORPHA:228123)
- Unusual CNS infection (HP:0011450): Increased susceptibility to infections of the central nervous system, as manifested by recurrent, severe, or invasive infections involving the brain, meninges, or spinal cord. This can include infections caused by opportunistic or atypical pathogens, or common pathogens presenting with unusual severity or in anatomical locations. Evidence: TAS. Frequency: Occasional (HP:0040283). (ORPHA:228123)
- Pleural empyema (HP:0011919): Accumulation of pus in the pleural cavity. Evidence: TAS. Frequency: Occasional (HP:0040283). (ORPHA:228123)
- Exudative pleural effusion (HP:0011921): A type of pleural effusion with a exudate (extravascular fluid that has exuded out of a tissue or its capillaries due to injury or inflammation). Pleural effusions can be classified as transudates or exudates based on Light's criteria, which classify an effusion as exudate if one or more of the following are present: (1) the ratio of pleural fluid protein to serum protein is greater than 0.5, (2) the ratio of pleural fluid lactate dehydrogenase (LDH) to serum LDH is greater than 0.6, or (3) the pleural fluid LDH level is greater than two thirds of the upper limit of normal for serum LDH. Evidence: TAS. Frequency: Occasional (HP:0040283). (ORPHA:228123)
- Hypoglycorrhachia (HP:0011972): Abnormally low glucose concentration in the cerebrospinal fluid. Evidence: TAS. Frequency: Occasional (HP:0040283). (ORPHA:228123)
- Erythema nodosum (HP:0012219): An erythematous eruption commonly associated with drug reactions or infection and characterized by inflammatory nodules that are usually tender, multiple, and bilateral. Evidence: TAS. Frequency: Occasional (HP:0040283). (ORPHA:228123)
- CSF pleocytosis (HP:0012229): An increased white blood cell count in the cerebrospinal fluid. Evidence: TAS. Frequency: Occasional (HP:0040283). (ORPHA:228123)
- Morbilliform rash (HP:0012282): An exanthema consisting of widespread pink-to-red macules (flat spots of 2-10 mm in diameter) or papules (red bumps) that blanch with pressure. The macules and papules may cluster and merge to form sheets over several days. Evidence: TAS. Frequency: Occasional (HP:0040283). (ORPHA:228123)
- Fatigue (HP:0012378): A subjective feeling of tiredness characterized by a lack of energy and motivation. Evidence: TAS. Frequency: Occasional (HP:0040283). (ORPHA:228123)
- Panniculitis (HP:0012490): Inflammation of subcutaneous adipose tissue. Evidence: TAS. Frequency: Occasional (HP:0040283). (ORPHA:228123)
- Verrucous papule (HP:0012500): A wartlike (with multiple small elevated projections) papule. Evidence: TAS. Frequency: Occasional (HP:0040283). (ORPHA:228123)
- Cough (HP:0012735): A sudden, audible expulsion of air from the lungs through a partially closed glottis, preceded by inhalation. Evidence: TAS. Frequency: Occasional (HP:0040283). (ORPHA:228123)
- Folliculitis (HP:0025084): Inflammatory cells within the wall and ostia of the hair follicle, creating a follicular-based pustule. Evidence: TAS. Frequency: Occasional (HP:0040283). (ORPHA:228123)
- Abscess (HP:0025615): An abscess is a localized collection of purulent material surrounded by inflammation and granulation. Evidence: TAS. Frequency: Occasional (HP:0040283). (ORPHA:228123)
- Urticarial plaque (HP:0030351): A well-circumscribed, intensely pruritic, raised wheal (edema of the superficial skin) typically 1 to 2 cm in diameter. Evidence: TAS. Frequency: Occasional (HP:0040283). (ORPHA:228123)
- Parenchymal consolidation (HP:0032177): Consolidation refers to an exudate or other product of disease that replaces alveolar air, rendering the lung solid (as in infective pneumonia). Evidence: TAS. Frequency: Occasional (HP:0040283). (ORPHA:228123)
- Indurated nodule (HP:0032217): A skin nodule that is unusually hard (indurated). Evidence: TAS. Frequency: Occasional (HP:0040283). (ORPHA:228123)
- Granuloma (HP:0032252): A compact, organized collection of mature mononuclear phagocytes, which may be but is not necessarily accompanied by accessory features such as necrosis. Evidence: TAS. Frequency: Occasional (HP:0040283). (ORPHA:228123)
- Mediastinal lymphadenopathy (HP:0100721): Swelling of lymph nodes within the mediastinum, the central compartment of the thoracic cavities that contains the heart and the great vessels, the esophagus, and trachea and other structures including lymph nodes. Evidence: TAS. Frequency: Occasional (HP:0040283). (ORPHA:228123)
- Chest pain (HP:0100749): An unpleasant sensation characterized by physical discomfort (such as pricking, throbbing, or aching) localized to the chest. Evidence: TAS. Frequency: Occasional (HP:0040283). (ORPHA:228123)
- Papule (HP:0200034): A circumscribed, solid elevation of skin with no visible fluid, varying in size from a pinhead to less than 10mm in diameter at the widest point. Evidence: TAS. Frequency: Occasional (HP:0040283). (ORPHA:228123)
- Skin plaque (HP:0200035): A plaque is a solid, raised, plateau-like (flat-topped) lesion greater than 1 cm in diameter. Evidence: TAS. Frequency: Occasional (HP:0040283). (ORPHA:228123)
- CSF lymphocytic pleiocytosis (HP:0200149): An increased lymphocyte count in the cerebrospinal fluid. Evidence: TAS. Frequency: Occasional (HP:0040283). (ORPHA:228123)
- Abnormality of the bladder (HP:0000014): An abnormality of the urinary bladder. Evidence: TAS. Frequency: Very rare (HP:0040284). (ORPHA:228123)
- Abnormality of the kidney (HP:0000077): An abnormality of the kidney. Evidence: TAS. Frequency: Very rare (HP:0040284). (ORPHA:228123)
- Renal insufficiency (HP:0000083): A reduction in the level of performance of the kidneys in areas of function comprising the concentration of urine, removal of wastes, the maintenance of electrolyte balance, homeostasis of blood pressure, and calcium metabolism. Evidence: TAS. Frequency: Very rare (HP:0040284). (ORPHA:228123)
- Abnormality of the genitourinary system (HP:0000119): The presence of any abnormality of the genitourinary system. Evidence: TAS. Frequency: Very rare (HP:0040284). (ORPHA:228123)
- Hydrocephalus (HP:0000238): Hydrocephalus is an active distension of the ventricular system of the brain resulting from inadequate passage of CSF from its point of production within the cerebral ventricles to its point of absorption into the systemic circulation. Evidence: TAS. Frequency: Very rare (HP:0040284). (ORPHA:228123)
- Hearing impairment (HP:0000365): A decreased magnitude of the sensory perception of sound. Evidence: TAS. Frequency: Very rare (HP:0040284). (ORPHA:228123)
- Abnormal retinal morphology (HP:0000479): A structural abnormality of the retina. Evidence: TAS. Frequency: Very rare (HP:0040284). (ORPHA:228123)
- Photophobia (HP:0000613): Excessive sensitivity to light with the sensation of discomfort or pain in the eyes due to exposure to bright light. Evidence: TAS. Frequency: Very rare (HP:0040284). (ORPHA:228123)
- Blurred vision (HP:0000622): Lack of sharpness of vision resulting in the inability to see fine detail. Evidence: TAS. Frequency: Very rare (HP:0040284). (ORPHA:228123)
- Personality changes (HP:0000751): An abnormal shift in patterns of thinking, acting, or feeling. Evidence: TAS. Frequency: Very rare (HP:0040284). (ORPHA:228123)
- Abnormality of the endocrine system (HP:0000818): An abnormality of the endocrine system. Evidence: TAS. Frequency: Very rare (HP:0040284). (ORPHA:228123)
- Broad ribs (HP:0000885): Increased width of ribs. Evidence: TAS. Frequency: Very rare (HP:0040284). (ORPHA:228123)
- Abnormality of the vertebral column (HP:0000925): Any abnormality of the vertebral column. Evidence: TAS. Frequency: Very rare (HP:0040284). (ORPHA:228123)
- Seizure (HP:0001250): A seizure is an intermittent abnormality of nervous system physiology characterized by a transient occurrence of signs and/or symptoms due to abnormal excessive or synchronous neuronal activity in the brain. Evidence: TAS. Frequency: Very rare (HP:0040284). (ORPHA:228123)
- Abnormality of the liver (HP:0001392): An abnormality of the liver. Evidence: TAS. Frequency: Very rare (HP:0040284). (ORPHA:228123)
- Pericarditis (HP:0001701): Inflammation of the sac-like covering around the heart (pericardium). Evidence: TAS. Frequency: Very rare (HP:0040284). (ORPHA:228123)
- Pancreatitis (HP:0001733): The presence of inflammation in the pancreas. Evidence: TAS. Frequency: Very rare (HP:0040284). (ORPHA:228123)
- Abnormality of the spleen (HP:0001743): An abnormality of the spleen. Evidence: TAS. Frequency: Very rare (HP:0040284). (ORPHA:228123)
- Broad metatarsal (HP:0001783): Increased side-to-side width of a metatarsal bone. Evidence: TAS. Frequency: Very rare (HP:0040284). (ORPHA:228123)
- Abnormality of blood and blood-forming tissues (HP:0001871): An abnormality of the hematopoietic system. Evidence: TAS. Frequency: Very rare (HP:0040284). (ORPHA:228123)
- Headache (HP:0002315): Cephalgia, or pain sensed in various parts of the head, not confined to the area of distribution of any nerve. Evidence: TAS. Frequency: Very rare (HP:0040284). (ORPHA:228123)
- Peritonitis (HP:0002586): Inflammation of the peritoneum. Evidence: TAS. Frequency: Very rare (HP:0040284). (ORPHA:228123)
- Vasculitis (HP:0002633): Inflammation of blood vessel. Evidence: TAS. Frequency: Very rare (HP:0040284). (ORPHA:228123)
- Cerebral ischemia (HP:0002637): Restriction of arterial blood supply to the brain associated with insufficient oxygenation to support the metabolic requirements of the tissue. Evidence: TAS. Frequency: Very rare (HP:0040284). (ORPHA:228123)
- Broad skull (HP:0002682): Increased width of the skull. Evidence: TAS. Frequency: Very rare (HP:0040284). (ORPHA:228123)
- Osteomyelitis (HP:0002754): Osteomyelitis is an inflammatory process accompanied by bone destruction and caused by an infecting microorganism. Evidence: TAS. Frequency: Very rare (HP:0040284). (ORPHA:228123)
- Osteolysis (HP:0002797): Osteolysis refers to the destruction of bone through bone resorption with removal or loss of calcium. Evidence: TAS. Frequency: Very rare (HP:0040284). (ORPHA:228123)
- Abnormal metacarpal morphology (HP:0005916): Any abnormal shape or structure of the metacarpal bones. Evidence: TAS. Frequency: Very rare (HP:0040284). (ORPHA:228123)
- Abnormality of the female genitalia (HP:0010460): Abnormality of the female genital system. Evidence: TAS. Frequency: Very rare (HP:0040284). (ORPHA:228123)
- Abnormality of the male genitalia (HP:0010461): Abnormality of the male genital system. Evidence: TAS. Frequency: Very rare (HP:0040284). (ORPHA:228123)
- Abnormal long bone morphology (HP:0011314): An abnormality of size or shape of the long bones. Evidence: TAS. Frequency: Very rare (HP:0040284). (ORPHA:228123)
- Abnormal sperm morphology (HP:0012864): A structural anomaly of sperm. Evidence: TAS. Frequency: Very rare (HP:0040284). (ORPHA:228123)
- Invasive fungal infection (HP:0020101): Fungal infection characterized by invasion of host tissues. Evidence: TAS. Frequency: Very rare (HP:0040284). (ORPHA:228123)
- Vasospasm (HP:0025637): Narrowing of an artery due to constriction of the blood vessels. Evidence: TAS. Frequency: Very rare (HP:0040284). (ORPHA:228123)
- Nuchal rigidity (HP:0031179): Resistance of the extensor muscles of the neck to being bent forwards (i.e., impaired neck flexion) as a result of muscle spasm of the extensor muscles of the neck. Nuchal rigidity is not a fixed rigidity. Nuchal rigidity has been used as a bedside test for meningism, although its sensitivity for this purpose has been debated. Evidence: TAS. Frequency: Very rare (HP:0040284). (ORPHA:228123)
- Coccidioidal meningitis (HP:0032161): A type of fungal meningitis caused by dissemination of coccidioides to basilar meninges. Evidence: TAS. Frequency: Very rare (HP:0040284). (ORPHA:228123)
- Cognitive impairment (HP:0100543): Abnormal cognition is characterized by deficits in thinking, reasoning, or remembering. Evidence: TAS. Frequency: Very rare (HP:0040284). (ORPHA:228123)